Phenotypes associated with the disease hyperthermia, cutaneous, with headaches and nausea (OMIM:145590):
- Vomiting (HP:0002013): Forceful ejection of the contents of the stomach through the mouth by means of a series of involuntary spasmic contractions. Evidence: IEA. (OMIM:145590)
- Fever (HP:0001945): Body temperature elevated above the normal range. Evidence: TAS. (OMIM:145590)
- Nausea (HP:0002018): A sensation of unease in the stomach together with an urge to vomit. Evidence: IEA. (OMIM:145590)
- Headache (HP:0002315): Cephalgia, or pain sensed in various parts of the head, not confined to the area of distribution of any nerve. Evidence: TAS. (OMIM:145590)
- Autosomal dominant inheritance (HP:0000006): A mode of inheritance that is observed for traits related to a gene encoded on one of the autosomes (i.e., the human chromosomes 1-22) in which a trait manifests in heterozygotes. In the context of medical genetics, an autosomal dominant disorder is caused when a single copy of the mutant allele is present. Males and females are affected equally, and can both transmit the disorder with a risk of 50% for each child of inheriting the mutant allele. Evidence: IEA. (OMIM:145590)